- Uveal melanoma (HP:0007716): A malignant melanoma originating within the eye. The tumor originates from the melanocytes in the uvea (which comprises the iris, ciliary body, and choroid). Evidence: PCS. (PMID:32239153)
- Adult onset (HP:0003581): Onset of disease manifestations in adulthood, defined here as at the age of 16 years or later. Evidence: PCS. (PMID:32239153)
- Autosomal dominant inheritance (HP:0000006): A mode of inheritance that is observed for traits related to a gene encoded on one of the autosomes (i.e., the human chromosomes 1-22) in which a trait manifests in heterozygotes. In the context of medical genetics, an autosomal dominant disorder is caused when a single copy of the mutant allele is present. Males and females are affected equally, and can both transmit the disorder with a risk of 50% for each child of inheriting the mutant allele. Evidence: PCS. (PMID:32239153)
These phenotypes are associated with the disease melanoma, uveal, susceptibility to, 1 (OMIM:606660).